Phenotypes associated with the disease neurodevelopmental disorder with language impairment and behavioral abnormalities (OMIM:618917):
- Bilateral tonic-clonic seizure (HP:0002069): A bilateral tonic-clonic seizure is a seizure defined by a tonic (bilateral increased tone, lasting seconds to minutes) and then a clonic (bilateral sustained rhythmic jerking) phase. Evidence: PCS. Frequency: 7/28. (PMID:31300657)
- Inability to walk (HP:0002540): Incapability to ambulate. Evidence: PCS. Frequency: 4/22. (PMID:31300657)
- Dystonia (HP:0001332): An abnormally increased muscular tone that causes fixed abnormal postures. There is a slow, intermittent twisting motion that leads to exaggerated turning and posture of the extremities and trunk. Evidence: PCS. Frequency: 1/22. (PMID:31300657)
- Cerebellar atrophy (HP:0001272): Cerebellar atrophy is defined as a cerebellum with initially normal structures, in a posterior fossa with normal size, which displays enlarged fissures (interfolial spaces) in comparison to the foliae secondary to loss of tissue. Cerebellar atrophy implies irreversible loss of tissue and result from an ongoing progressive disease until a final stage is reached or a single injury, e.g. an intoxication or infectious event. Evidence: PCS. Frequency: 6/23. (PMID:31300657)
- Gait ataxia (HP:0002066): A type of ataxia characterized by the impairment of the ability to coordinate the movements required for normal walking. Gait ataxia is characteirzed by a wide-based staggering gait with a tendency to fall. Evidence: PCS. Frequency: 1/22. (PMID:31300657)
- Clonic seizure (HP:0020221): A clonic seizure is a type of motor seizure characterized by sustained rhythmic jerking, that is regularly repetitive. Evidence: PCS. Frequency: 3/28. (PMID:31300657)
- Motor stereotypy (HP:0000733): Use of the same abnormal action in response to certain triggers or at random. They may be used as a way to regulate one's internal state but must otherwise have no apparent functional purpose. Evidence: PCS. Frequency: 2/22. (PMID:31300657)
- Stereotypical hand wringing (HP:0012171): Habitual clasping and wringing of the hands in the middle of the body, similar to a hand-washing movement. Evidence: PCS. (PMID:31300657)
- Intellectual disability (HP:0001249): The term intellectual disability or intellectual developmental disorder is used to describe significantly sub-average intellectual and adaptive functioning based on clinical assessment and as measured by individually administered, appropriately normed, standardized and validated tests of intellectual functioning and adaptive behavior, with onset during the developmental period from infancy through adolescence. Evidence: PCS. Frequency: 28/28. (PMID:31300657)
- Progressive microcephaly (HP:0000253): Progressive microcephaly is diagnosed when the head circumference falls progressively behind age- and gender-dependent norms. Evidence: PCS. Frequency: 4/28. Onset: Infantile onset (HP:0003593). (PMID:31300657)
- Cerebral atrophy (HP:0002059): Atrophy (wasting, decrease in size of cells or tissue) affecting the cerebrum. Evidence: PCS. Frequency: 4/23. (PMID:31300657)
- Absent speech (HP:0001344): Complete lack of development of speech and language abilities. Evidence: PCS. Frequency: 14/25. (PMID:31300657)
- Delayed speech and language development (HP:0000750): A degree of language development that is significantly below the norm for a child of a specified age. Evidence: PCS. Frequency: 11/25. (PMID:31300657)
- Talipes equinovarus (HP:0001762): Talipes equinovarus (also called clubfoot) typically has four main components: inversion and adduction of the forefoot; inversion of the heel and hindfoot; equinus (limitation of extension) of the ankle and subtalar joint; and internal rotation of the leg. Evidence: PCS. Frequency: 1/22. Onset: Congenital onset (HP:0003577). (PMID:31300657)
- Febrile seizure (within the age range of 3 months to 6 years) (HP:0002373): A febrile seizure is any type of seizure (most often a generalized tonic-clonic seizure) occurring with fever (at least 38 degrees Celsius) but in the absence of central nervous system infection, severe metabolic disturbance or other alternative precipitant in children between the ages of 3 months and 6 years. Evidence: PCS. Frequency: 1/28. (PMID:31300657)
- Global developmental delay (HP:0001263): A delay in the achievement of motor or mental milestones in the domains of development of a child, including motor skills, speech and language, cognitive skills, and social and emotional skills. This term should only be used to describe children younger than five years of age. Evidence: PCS. Frequency: 28/28. (PMID:31300657)
- Chorea (HP:0002072): Chorea (Greek for 'dance') refers to widespread arrhythmic involuntary movements of a forcible, jerky and restless fashion. It is a random-appearing sequence of one or more discrete involuntary movements or movement fragments. Movements appear random because of variability in timing, duration or location. Each movement may have a distinct start and end. However, movements may be strung together and thus may appear to flow randomly from one muscle group to another. Chorea can involve the trunk, neck, face, tongue, and extremities. Evidence: PCS. Frequency: 1/22. (PMID:31300657)
- Tonic seizure (HP:0032792): A tonic seizure is a type of motor seizure characterized by unilateral or bilateral limb stiffening or elevation, often with neck stiffening. Evidence: PCS. Frequency: 1/28. (PMID:31300657)
- Autistic behavior (HP:0000729): Persistent deficits in social interaction and communication and interaction as well as a markedly restricted repertoire of activity and interest as well as repetitive patterns of behavior. Evidence: PCS. Frequency: 17/22. (PMID:31300657)
- Compulsive behaviors (HP:0000722): Behavior that consists of repetitive acts, characterized by the feeling that one "has to" perform them, while being aware that these acts are not in line with one's overall goal. Evidence: PCS. Frequency: 2/22. (PMID:31300657)
- Self-injurious behavior (HP:0100716): Self-aggression. Evidence: PCS. Frequency: 1/22. (PMID:31300657)
- Focal-onset seizure (HP:0007359): A focal-onset seizure is a type of seizure originating within networks limited to one hemisphere. They may be discretely localized or more widely distributed, and may originate in subcortical structures. Evidence: PCS. Frequency: 8/28. (PMID:31300657)
- Spasticity (HP:0001257): A motor disorder characterized by a velocity-dependent increase in tonic stretch reflexes with increased muscle tone, exaggerated (hyperexcitable) tendon reflexes. Evidence: PCS. Frequency: 1/22. (PMID:31300657)
- Autosomal dominant inheritance (HP:0000006): A mode of inheritance that is observed for traits related to a gene encoded on one of the autosomes (i.e., the human chromosomes 1-22) in which a trait manifests in heterozygotes. In the context of medical genetics, an autosomal dominant disorder is caused when a single copy of the mutant allele is present. Males and females are affected equally, and can both transmit the disorder with a risk of 50% for each child of inheriting the mutant allele. Evidence: PCS. (PMID:31300657)
- Cryptorchidism (HP:0000028): Testis in inguinal canal. That is, absence of one or both testes from the scrotum owing to failure of the testis or testes to descend through the inguinal canal to the scrotum. Evidence: PCS. Frequency: 1/15. (PMID:31300657)